Phenotypes associated with the disease Cleidorhizomelic syndrome (ORPHA:1453):
- Abnormal clavicle morphology (HP:0000889): Any abnormality of the clavicles (collar bones). Evidence: TAS. Frequency: Very frequent (HP:0040281). (ORPHA:1453)
- Brachydactyly (HP:0001156): Digits that appear disproportionately short compared to the hand/foot. The word brachydactyly is used here to describe a series distinct patterns of shortened digits (brachydactyly types A-E). This is the sense used here. Evidence: TAS. Frequency: Very frequent (HP:0040281). (ORPHA:1453)
- Clinodactyly of the 5th finger (HP:0004209): Clinodactyly refers to a bending or curvature of the fifth finger in the radial direction (i.e., towards the 4th finger). Evidence: TAS. Frequency: Very frequent (HP:0040281). (ORPHA:1453)
- Short middle phalanx of the 5th finger (HP:0004220): Hypoplastic/small middle phalanx of the fifth finger. Evidence: TAS. Frequency: Very frequent (HP:0040281). (ORPHA:1453)
- Diaphyseal undertubulation (HP:0005019): Tubulation refers to the size and shape of tubular bones. In children and adolescents, the modeling process regulates normal bone growth. Final shaft (tube) diameter depends on appositional bone growth and the equilibrium between periosteal and endosteal bone resorption and formation. Undertubulation refers to a broad, widened form of the shafts (diaphyses) of long bones. Evidence: TAS. Frequency: Very frequent (HP:0040281). (ORPHA:1453)
- Bilateral single transverse palmar creases (HP:0007598): The distal and proximal transverse palmar creases are merged into a single transverse palmar crease on both hands. Evidence: TAS. Frequency: Frequent (HP:0040282). (ORPHA:1453)
- Rhizomelia (HP:0008905): Disproportionate shortening of the proximal segment of limbs (i.e. the femur and humerus). Evidence: TAS. Frequency: Very frequent (HP:0040281). (ORPHA:1453)